- Reduced visual acuity (HP:0007663). Evidence: TAS. Frequency: Very frequent (HP:0040281). (ORPHA:79098)
- Glaucoma (HP:0000501): Glaucoma refers loss of retinal ganglion cells in a characteristic pattern of optic neuropathy usually associated with increased intraocular pressure. Evidence: TAS. Frequency: Frequent (HP:0040282). (ORPHA:79098)
- Cataract (HP:0000518): A cataract is an opacity or clouding that develops in the crystalline lens of the eye or in its capsule. Evidence: TAS. Frequency: Frequent (HP:0040282). (ORPHA:79098)
- Retinal detachment (HP:0000541): Separation of the inner layers of the retina (neural retina) from the pigment epithelium. Evidence: TAS. Frequency: Frequent (HP:0040282). (ORPHA:79098)
- Vitritis (HP:0011531): Inflammation of the vitreous body, characterized by the presence of inflammatory cells and protein exudate in the vitreous cavity. Evidence: TAS. Frequency: Frequent (HP:0040282). (ORPHA:79098)
- Corneal keratic precipitates (HP:0025341): An inflammatory cellular deposit deposited on the corneal endothelium and visible as spots on the cornea. Evidence: TAS. Frequency: Frequent (HP:0040282). (ORPHA:79098)
- Anterior chamber cells (HP:0025560): Tiny deposits corresponding to cells floating in the anterior chamber of the eye. This appearance is typically associated with intraocular inflammation leading to breakdown of the blood-aqueous barrier and resulting in an increase in the number of cells and in the aqueous humor. Grading (SUN Working Group) is performed by estimating the number of cells in a 1 mm by 1 mm slit beam field, employing adequate light intensity and magnification on a slit lamp. Evidence: TAS. Frequency: Frequent (HP:0040282). (ORPHA:79098)
- Scleral thickening (HP:0030823): Increased dimension of the sclera in the anterior-posterior axis. Evidence: TAS. Frequency: Frequent (HP:0040282). (ORPHA:79098)
- Tinnitus (HP:0000360): Tinnitus is an auditory perception that can be described as the experience of sound, in the ear or in the head, in the absence of external acoustic stimulation. Evidence: TAS. Frequency: Occasional (HP:0040283). (ORPHA:79098)
- Hearing impairment (HP:0000365): A decreased magnitude of the sensory perception of sound. Evidence: TAS. Frequency: Occasional (HP:0040283). (ORPHA:79098)
- Retinal hemorrhage (HP:0000573): Bleeding located within the retina. Retinal hemorrhages range from the smallest dot and blot hemorrhage to massive sub-hyaloid hemorrhage. Evidence: TAS. Frequency: Occasional (HP:0040283). (ORPHA:79098)
- Photophobia (HP:0000613): Excessive sensitivity to light with the sensation of discomfort or pain in the eyes due to exposure to bright light. Evidence: TAS. Frequency: Occasional (HP:0040283). (ORPHA:79098)
- Vitiligo (HP:0001045). Evidence: TAS. Frequency: Occasional (HP:0040283). (ORPHA:79098)
- Papilledema (HP:0001085): Papilledema refers to edema (swelling) of the optic disc secondary to any factor which increases cerebral spinal fluid pressure. Evidence: TAS. Frequency: Occasional (HP:0040283). (ORPHA:79098)
- Alopecia (HP:0001596): A noncongenital process of hair loss, which may progress to partial or complete baldness. Evidence: TAS. Frequency: Occasional (HP:0040283). (ORPHA:79098)
- Poliosis (HP:0002290): Circumscribed depigmentation of the hair of the head or the eyelashes. Evidence: TAS. Frequency: Occasional (HP:0040283). (ORPHA:79098)
- Headache (HP:0002315): Cephalgia, or pain sensed in various parts of the head, not confined to the area of distribution of any nerve. Evidence: TAS. Frequency: Occasional (HP:0040283). (ORPHA:79098)
- Fundus hypopigmentation (HP:0007894): Generalized or focal reduced pigmentation of the fundus, evaluated in the context of skin and hair color. Fundoscopy may reveal a low level pigment. Evidence: TAS. Frequency: Occasional (HP:0040283). (ORPHA:79098)
- Ocular hypertension (HP:0007906): Intraocular pressure that is 2 standard deviations above the population mean. Evidence: TAS. Frequency: Occasional (HP:0040283). (ORPHA:79098)
- Erythema (HP:0010783): Redness of the skin, caused by hyperemia of the capillaries in the lower layers of the skin. Evidence: TAS. Frequency: Occasional (HP:0040283). (ORPHA:79098)
- Posterior synechiae of the anterior chamber (HP:0011484): Adhesions between the iris and the lens. Evidence: TAS. Frequency: Occasional (HP:0040283). (ORPHA:79098)
- Posterior uveitis (HP:0012123): Inflammation of the uveal tract in which the primary site of inflammation is the retina or choroid. Evidence: TAS. Frequency: Occasional (HP:0040283). (ORPHA:79098)
- Macular edema (HP:0040049): Thickening of the retina that takes place due to accumulation of extracellular fluid in the macula as a nonspecific response to blood-retinal barrier breakdown. It can either have a cystoid aspect in the fovea, or a more diffuse aspect. Evidence: TAS. Frequency: Occasional (HP:0040283). (ORPHA:79098)
- Vitreous floaters (HP:0100832): Deposits of various size, shape, consistency, refractive index, and motility within the eye's vitreous humor, which is normally transparent. Evidence: TAS. Frequency: Occasional (HP:0040283). (ORPHA:79098)
- Ocular pain (HP:0200026): An unpleasant sensation characterized by physical discomfort (such as pricking, throbbing, or aching) localized to the eye. Evidence: TAS. Frequency: Occasional (HP:0040283). (ORPHA:79098)
- Dalen-Fuchs nodules (HP:6000710): Nodules (yellow-white subretinal pigment epithelium lesions) that form between Bruch membrane and the retinal pigment epithelium. Evidence: TAS. Frequency: Occasional (HP:0040283). (ORPHA:79098)
These phenotypes are associated with the disease Sympathetic ophthalmia (ORPHA:79098).